Phenotypes associated with the disease congenital disorder of glycosylation, type IIq (OMIM:617395):
- Spastic tetraplegia (HP:0002510): Spastic paralysis affecting all four limbs. Evidence: PCS. Frequency: 1/1. (PMID:24784932)
- Decreased circulating ceruloplasmin concentration (HP:0010837): The concentration of ceruloplasmin in the blood circulation is below the lower limit of normal. Evidence: PCS. Frequency: 1/1. (PMID:24784932)
- Hypoplasia of the corpus callosum (HP:0002079): Underdevelopment of the corpus callosum. Evidence: PCS. Frequency: 1/1. (PMID:24784932)
- Global developmental delay (HP:0001263): A delay in the achievement of motor or mental milestones in the domains of development of a child, including motor skills, speech and language, cognitive skills, and social and emotional skills. This term should only be used to describe children younger than five years of age. Evidence: PCS. Frequency: 1/1. (PMID:24784932)
- Hypotonia (HP:0001252): Hypotonia is an abnormally low muscle tone (the amount of tension or resistance to movement in a muscle). Even when relaxed, muscles have a continuous and passive partial contraction which provides some resistance to passive stretching. Hypotonia thus manifests as diminished resistance to passive stretching. Hypotonia is not the same as muscle weakness, although the two conditions can co-exist. Evidence: PCS. Frequency: 0/1. (PMID:24784932)
- Generalized tonic seizure (HP:0010818): A generalized tonic seizure is a type of generalized motor seizure characterized by bilateral limb stiffening or elevation, often with neck stiffening without a subsequent clonic phase. The tonic activity can be a sustained abnormal posture, either in extension or flexion, sometimes accompanied by tremor of the extremities. Evidence: PCS. Frequency: 1/1. (PMID:24784932)
- Infantile onset (HP:0003593): Onset of signs or symptoms of disease between 28 days to one year of life. Evidence: PCS. Frequency: 1/1. (PMID:24784932)
- Secondary microcephaly (HP:0005484): Head circumference which falls below 2 standard deviations below the mean for age and gender because of insufficient head growth after birth. Evidence: PCS. Frequency: 1/1. (PMID:24784932)
- Small pituitary gland (HP:0012506): An abnormally decreased size of the pituitary gland. Evidence: PCS. Frequency: 1/1. (PMID:24784932)
- Decreased circulating copper concentration (HP:0011967): The concentration of copper cation in the blood circulation is below the lower limit of normal. Evidence: PCS. Frequency: 1/1. (PMID:24784932)
- Abnormal glycosylation (HP:0012345): An anomaly of a glycosylation process, i.e., a process involved in the covalent attachment of a glycosyl residue to a substrate molecule. Evidence: PCS. Frequency: 1/1. (PMID:24784932)
- Diffuse cerebral atrophy (HP:0002506): Diffuse unlocalised atrophy affecting the cerebrum. Evidence: PCS. Frequency: 1/1. (PMID:24784932)
- Autosomal recessive inheritance (HP:0000007): A mode of inheritance that is observed for traits related to a gene encoded on one of the autosomes (i.e., the human chromosomes 1-22) in which a trait manifests in individuals with two pathogenic alleles, either homozygotes (two copies of the same mutant allele) or compound heterozygotes (whereby each copy of a gene has a distinct mutant allele). Evidence: PCS. (PMID:24784932)
- Elevated circulating hepatic transaminase concentration (HP:0002910): Elevations of the levels of SGOT and SGPT in the serum. SGOT (serum glutamic oxaloacetic transaminase) and SGPT (serum glutamic pyruvic transaminase) are transaminases primarily found in the liver and heart and are released into the bloodstream as the result of liver or heart damage. SGOT and SGPT are used clinically mainly as markers of liver damage. Evidence: PCS. Frequency: 1/1. (PMID:24784932)